- Vomiting (HP:0002013): Forceful ejection of the contents of the stomach through the mouth by means of a series of involuntary spasmic contractions. Evidence: PCS. Frequency: 1/1. (PMID:11231969)
- Increased circulating renin concentration (HP:0000848): An increased level of renin in the blood. Evidence: PCS. Frequency: 1/1. (PMID:11231969)
- Hyperkalemia (HP:0002153): The concentration of potassium(1+) in the blood circulation is above the upper limit of normal. Evidence: PCS. Frequency: 1/1. (PMID:11231969)
- Increased circulating aldosterone concentration (HP:0000859): Overproduction of the mineralocorticoid aldosterone by the adrenal cortex. Evidence: PCS. Frequency: 1/1. (PMID:11231969)
- Dehydration (HP:0001944). Evidence: PCS. Frequency: 1/1. (PMID:11231969)
- Hyponatremia (HP:0002902): The concentration of sodium in the blood circulation is below the lower limit of normal. Evidence: PCS. Frequency: 1/1. (PMID:11231969)
- Autosomal recessive inheritance (HP:0000007): A mode of inheritance that is observed for traits related to a gene encoded on one of the autosomes (i.e., the human chromosomes 1-22) in which a trait manifests in individuals with two pathogenic alleles, either homozygotes (two copies of the same mutant allele) or compound heterozygotes (whereby each copy of a gene has a distinct mutant allele). Evidence: PCS. (PMID:8640238)
- Metabolic acidosis (HP:0001942): Metabolic acidosis (MA) is characterized by a fall in blood pH due to a reduction of serum bicarbonate concentration. This can occur as a result of either the accumulation of acids (high anion gap MA) or the loss of bicarbonate from the gastrointestinal tract or the kidney (hyperchloremic MA). By definition, MA is not due to a respirary cause. Evidence: PCS. Frequency: 1/1. (PMID:11231969)
- Neonatal onset (HP:0003623): Onset of signs or symptoms of disease within the first 28 days of life. Evidence: PCS. Frequency: 1/1. (PMID:11231969)
These phenotypes are associated with the disease pseudohypoaldosteronism, type IB3, autosomal recessive (OMIM:620126).